Phenotypes associated with the disease Usher syndrome type 1G (OMIM:606943):
- Abnormal vestibular function (HP:0001751): An abnormality of the functioning of the vestibular apparatus. Evidence: IEA. (OMIM:606943)
- Sensorineural hearing impairment (HP:0000407): A type of hearing impairment in one or both ears related to an abnormal functionality of the cochlear nerve. Evidence: TAS. (OMIM:606943)
- Autosomal recessive inheritance (HP:0000007): A mode of inheritance that is observed for traits related to a gene encoded on one of the autosomes (i.e., the human chromosomes 1-22) in which a trait manifests in individuals with two pathogenic alleles, either homozygotes (two copies of the same mutant allele) or compound heterozygotes (whereby each copy of a gene has a distinct mutant allele). Evidence: IEA. (OMIM:606943)
- Rod-cone dystrophy (HP:0000510): An inherited retinal disease subtype in which the rod photoreceptors appear to be more severely affected than the cone photoreceptors. Typical presentation is with nyctalopia (due to rod dysfunction) followed by loss of mid-peripheral field of vision, which gradually extends and leaves many patients with a small central island of vision due to the preservation of macular cones. Evidence: IEA. (OMIM:606943)
- Hypoplasia of the nasal bone (HP:0004646): Underdevelopment of the nasal bone. Evidence: IEA. (OMIM:606943)